- Congenital earlobe sinuses (HP:0004461): Pits in the earlobes at the location where ears are typically pierced for earrings. Evidence: TAS. (OMIM:129000)
- Autosomal dominant inheritance (HP:0000006): A mode of inheritance that is observed for traits related to a gene encoded on one of the autosomes (i.e., the human chromosomes 1-22) in which a trait manifests in heterozygotes. In the context of medical genetics, an autosomal dominant disorder is caused when a single copy of the mutant allele is present. Males and females are affected equally, and can both transmit the disorder with a risk of 50% for each child of inheriting the mutant allele. Evidence: TAS. (OMIM:129000)
These phenotypes are associated with the disease Earring holes, natural (OMIM:129000).